Phenotypes associated with the disease orofacial cleft 10 (OMIM:613705):
- Congenital onset (HP:0003577): A phenotypic abnormality that is present at birth. Evidence: PCS. Frequency: 1/1. (PMID:16990542)
- Unilateral cleft palate (HP:0100334). Evidence: PCS. Frequency: 1/1. (PMID:16990542)
- Sporadic (HP:0003745): Cases of the disease in question occur without a previous family history, i.e., as isolated cases without being transmitted from a parent and without other siblings being affected. Evidence: PCS. (PMID:16990542)
- Unilateral cleft lip (HP:0100333): A non-midline cleft of the upper lip on one side only. Evidence: PCS. Frequency: 1/1. (PMID:16990542)